Phenotypes associated with the disease intellectual disability, X-linked 73 (OMIM:300355):
- Mild intellectual disability (HP:0001256): Mild intellectual disability (ID) is defined as a type of ID characterized by mildly sub-average adaptive functioning and intellectual functioning, with an intelligence quotient (IQ) the range of 50-69. Evidence: IEA. (OMIM:300355)
- X-linked recessive inheritance (HP:0001419): A mode of inheritance that is observed for recessive traits related to a gene encoded on the X chromosome. In the context of medical genetics, X-linked recessive disorders manifest in males (who have one copy of the X chromosome and are thus hemizygotes), but generally not in female heterozygotes who have one mutant and one normal allele. Evidence: TAS. (OMIM:300355)
- X-linked inheritance (HP:0001417): A mode of inheritance that is observed for traits related to a gene encoded on the X chromosome. Evidence: IEA. (OMIM:300355)
- Synophrys (HP:0000664): Meeting of the medial eyebrows in the midline. Evidence: TAS. (OMIM:300355)